- Reduced volume of central subdivision of bed nucleus of stria terminalis (HP:0030797): A diminished volume of the central part of the bed nucleus of the stria terminalis. Evidence: PCS. (PMID:7477289)
- Abnormality of the nervous system (HP:0000707): An abnormality of the nervous system. Evidence: IEA. (OMIM:600952)
These phenotypes are associated with the disease TRANSSEXUALITY (OMIM:600952).